- Hip dysplasia (HP:0001385): The presence of developmental dysplasia of the hip. Evidence: IEA. (OMIM:302802)
- Steppage gait (HP:0003376): An abnormal gait pattern that arises from weakness of the pretibial and peroneal muscles due to a lower motor neuron lesion. Affected patients have footdrop and are unable to dorsiflex and evert the foot. The leg is lifted high on walking so that the toes clear the ground, and there may be a slapping noise when the foot strikes the ground again. Evidence: IEA. (OMIM:302802)
- Scoliosis (HP:0002650): The presence of an abnormal lateral curvature of the spine. Evidence: IEA. (OMIM:302802)
- Pes cavus (HP:0001761): An increase in height of the medial longitudinal arch of the foot that does not flatten on weight bearing (i.e., a distinctly hollow form of the sole of the foot when it is bearing weight). Evidence: IEA. (OMIM:302802)
- Distal amyotrophy (HP:0003693): Muscular atrophy affecting muscles in the distal portions of the extremities. Evidence: IEA. (OMIM:302802)
- Upper limb muscle weakness (HP:0003484): Weakness of the muscles of the arms. Evidence: IEA. (OMIM:302802)
- Paraparesis (HP:0002385): Weakness or partial paralysis in the lower limbs. Evidence: IEA. (OMIM:302802)
- EMG: axonal abnormality (HP:0003482): Electromyographic (EMG) findings characteristic of axonal neuropathy, with normal or slightly decreased nerve conduction velocities, normal or slightly prolonged distal latencies, but significantly reduced motor potentials and sensory amplitudes. There may be spontaneous activity upon needle EMG studies, such as increased insertional activity, positive sharp waves, and fibrillation potentials. Evidence: IEA. (OMIM:302802)
- Areflexia (HP:0001284): Absence of neurologic reflexes such as the knee-jerk reaction. Evidence: IEA. (OMIM:302802)
- Distal muscle weakness (HP:0002460): Reduced strength of the musculature of the distal extremities. Evidence: IEA. (OMIM:302802)
- X-linked recessive inheritance (HP:0001419): A mode of inheritance that is observed for recessive traits related to a gene encoded on the X chromosome. In the context of medical genetics, X-linked recessive disorders manifest in males (who have one copy of the X chromosome and are thus hemizygotes), but generally not in female heterozygotes who have one mutant and one normal allele. Evidence: IEA. (OMIM:302802)
- Foot dorsiflexor weakness (HP:0009027): Weakness of the muscles responsible for dorsiflexion of the foot, that is, of the movement of the toes towards the shin. The foot dorsiflexors include the tibialis anterior, the extensor hallucis longus, the extensor digitorum longus, and the peroneus tertius muscles. Evidence: IEA. (OMIM:302802)
- Distal sensory impairment (HP:0002936): An abnormal reduction in sensation in the distal portions of the extremities. Evidence: IEA. (OMIM:302802)
- Decreased nerve conduction velocity (HP:0000762): A reduction in the speed at which electrical signals propagate along the axon of a neuron. Evidence: IEA. (OMIM:302802)
These phenotypes are associated with the disease Charcot-Marie-Tooth disease X-linked recessive 3 (OMIM:302802).